- Bilateral tonic-clonic seizure (HP:0002069): A bilateral tonic-clonic seizure is a seizure defined by a tonic (bilateral increased tone, lasting seconds to minutes) and then a clonic (bilateral sustained rhythmic jerking) phase. Evidence: PCS. Frequency: 2/2. (PMID:24153177)
- Upslanted palpebral fissure (HP:0000582): The palpebral fissure inclination is more than two standard deviations above the mean for age (objective); or, the inclination of the palpebral fissure is greater than typical for age. Evidence: PCS. Frequency: 1/2. (PMID:24153177)
- Status epilepticus (HP:0002133): Status epilepticus is a type of prolonged seizure resulting either from the failure of the mechanisms responsible for seizure termination or from the initiation of mechanisms which lead to abnormally prolonged seizures (after time point t1). It is a condition that can have long-term consequences (after time point t2), including neuronal death, neuronal injury, and alteration of neuronal networks, depending on the type and duration of seizures. Evidence: PCS. Frequency: 1/2. (PMID:24153177)
- Anteverted nares (HP:0000463): Anteriorly-facing nostrils viewed with the head in the Frankfurt horizontal and the eyes of the observer level with the eyes of the subject. This gives the appearance of an upturned nose (upturned nasal tip). Evidence: PCS. Frequency: 1/2. (PMID:24153177)
- Global developmental delay (HP:0001263): A delay in the achievement of motor or mental milestones in the domains of development of a child, including motor skills, speech and language, cognitive skills, and social and emotional skills. This term should only be used to describe children younger than five years of age. Evidence: PCS. Frequency: 1/2. (PMID:24153177)
- Polyphagia (HP:0002591): A neurological anomaly with gross overeating associated with an abnormally strong desire or need to eat. Evidence: TAS. (OMIM:615538)
- Impulsivity (HP:0100710): Acting on the spur of the moment or on a momentary basis without consideration of outcomes; having difficulty establishing or following plans; experiencing a sense of urgency and engaging in behavior that is uninhibited, cannot be inhibited, and is uncontrolled. The possibility of repression is inconceivable. Evidence: PCS. Frequency: 1/2. (PMID:24153177)
- Narrow nasal ridge (HP:0000418): Decreased width of the nasal ridge. Evidence: PCS. Frequency: 1/2. (PMID:24153177)
- Emotional lability (HP:0000712): Unstable emotional experiences and frequent mood changes; emotions that are easily aroused, intense, and/or disproportionate to events and circumstances. Evidence: PCS. Frequency: 1/2. (PMID:24153177)
- Short attention span (HP:0000736): Reduced attention span characterized by distractibility and impulsivity. Evidence: PCS. Frequency: 1/2. (PMID:24153177)
- Bipolar affective disorder (HP:0007302): Bipolar disorder is an illness of mood characterized by alternating episodes of elevated and depressed moods, which are interspersed with euthymic periods. Evidence: PCS. Frequency: 1/2. (PMID:24153177)
- Epicanthus inversus (HP:0000537): A fold of skin starting at or just below the medial aspect of the lower lid and arching upward to cover, extend in front of and lateral to the medial canthus. Evidence: PCS. Frequency: 1/2. (PMID:24153177)
- Sporadic (HP:0003745): Cases of the disease in question occur without a previous family history, i.e., as isolated cases without being transmitted from a parent and without other siblings being affected. Evidence: PCS. (PMID:24153177)
- Attention deficit hyperactivity disorder (HP:0007018): Attention deficit hyperactivity disorder (ADHD) manifests at age 2-3 years or by first grade at the latest. The main symptoms are distractibility, impulsivity, hyperactivity, and often trouble organizing tasks and projects, difficulty going to sleep, and social problems from being aggressive, loud, or impatient. Evidence: PCS. Frequency: 1/2. (PMID:24153177)
These phenotypes are associated with the disease chromosome 22q13 duplication syndrome (OMIM:615538).